Phenotypes associated with the disease Drug metabolism, poor, cyp2d6-relateddrug metabolism, ultrarapid, cyp2d6-related, included (OMIM:608902):
- Neoplasm (HP:0002664): An organ or organ-system abnormality that consists of uncontrolled autonomous cell-proliferation which can occur in any part of the body as a benign or malignant neoplasm (tumor). Evidence: IEA. (OMIM:608902)
- Abnormality of metabolism/homeostasis (HP:0001939). Evidence: IEA. (OMIM:608902)
- Autosomal recessive inheritance (HP:0000007): A mode of inheritance that is observed for traits related to a gene encoded on one of the autosomes (i.e., the human chromosomes 1-22) in which a trait manifests in individuals with two pathogenic alleles, either homozygotes (two copies of the same mutant allele) or compound heterozygotes (whereby each copy of a gene has a distinct mutant allele). Evidence: TAS. (OMIM:608902)